Phenotypes associated with the disease Pancreatoblastoma (ORPHA:677, an Orphanet rare-disease identifier):
- Weight loss (HP:0001824, a Human Phenotype Ontology term): Reduction of total body weight. Evidence: TAS. Frequency: Frequent (HP:0040282, a Human Phenotype Ontology term). (ORPHA:677)
- Vomiting (HP:0002013, a Human Phenotype Ontology term): Forceful ejection of the contents of the stomach through the mouth by means of a series of involuntary spasmic contractions. Evidence: TAS. Frequency: Frequent (HP:0040282, a Human Phenotype Ontology term). (ORPHA:677)
- Diarrhea (HP:0002014, a Human Phenotype Ontology term): Abnormally increased frequency (usually defined as three or more) loose or watery bowel movements a day. Evidence: TAS. Frequency: Frequent (HP:0040282, a Human Phenotype Ontology term). (ORPHA:677)
- Abdominal pain (HP:0002027, a Human Phenotype Ontology term): An unpleasant sensation characterized by physical discomfort (such as pricking, throbbing, or aching) and perceived to originate in the abdomen. Evidence: TAS. Frequency: Frequent (HP:0040282, a Human Phenotype Ontology term). (ORPHA:677)
- Abdominal distention (HP:0003270, a Human Phenotype Ontology term): Distention of the abdomen. Evidence: TAS. Frequency: Frequent (HP:0040282, a Human Phenotype Ontology term). (ORPHA:677)
- Pancreatic calcification (HP:0005213, a Human Phenotype Ontology term): The presence of abnormal calcium deposition lesions in the pancreas. Evidence: TAS. Frequency: Frequent (HP:0040282, a Human Phenotype Ontology term). (ORPHA:677)
- Jaundice (HP:0000952, a Human Phenotype Ontology term): Yellow pigmentation of the skin due to bilirubin, which in turn is the result of increased bilirubin concentration in the bloodstream. Evidence: TAS. Frequency: Occasional (HP:0040283, a Human Phenotype Ontology term). (ORPHA:677)
- Abnormal lymph node morphology (HP:0002733, a Human Phenotype Ontology term): A structural lymph node abnormality. Evidence: TAS. Frequency: Occasional (HP:0040283, a Human Phenotype Ontology term). (ORPHA:677)
- Elevated maternal circulating alpha-fetoprotein concentration (HP:0011432, a Human Phenotype Ontology term): Increase in the levels of maternal serum alpha-fetoprotein levels during pregnancy. Evidence: TAS. Frequency: Frequent (HP:0040282, a Human Phenotype Ontology term). (ORPHA:677)